Phenotypes associated with the disease X-linked corneal dermoid (ORPHA:1661):
- Visual impairment (HP:0000505): Visual impairment (or vision impairment) is vision loss (of a person) to such a degree as to qualify as an additional support need through a significant limitation of visual capability resulting from either disease, trauma, or congenital or degenerative conditions that cannot be corrected by conventional means, such as refractive correction, medication, or surgery. Evidence: TAS. Frequency: Very frequent (HP:0040281). (ORPHA:1661)
- Visual loss (HP:0000572): Loss of visual acuity (implying that vision was better at a certain time point in life). Otherwise the term reduced visual acuity should be used (or a subclass of that). Evidence: TAS. Frequency: Occasional (HP:0040283). (ORPHA:1661)
- Abnormal pupil morphology (HP:0000615): An abnormality of the pupil. Evidence: TAS. Frequency: Frequent (HP:0040282). (ORPHA:1661)
- Corneal opacity (HP:0007957): A reduction of corneal clarity. Evidence: TAS. Frequency: Very frequent (HP:0040281). (ORPHA:1661)